Phenotypes associated with the disease Pseudodiastrophic dysplasia (ORPHA:85174):
- Malar flattening (HP:0000272): Underdevelopment of the malar prominence of the jugal bone (zygomatic bone in mammals), appreciated in profile, frontal view, and/or by palpation. Evidence: TAS. Frequency: Very frequent (HP:0040281). (ORPHA:85174)
- Platyspondyly (HP:0000926): A flattened vertebral body shape with reduced distance between the vertebral endplates. Evidence: TAS. Frequency: Very frequent (HP:0040281). (ORPHA:85174)
- Talipes equinovarus (HP:0001762): Talipes equinovarus (also called clubfoot) typically has four main components: inversion and adduction of the forefoot; inversion of the heel and hindfoot; equinus (limitation of extension) of the ankle and subtalar joint; and internal rotation of the leg. Evidence: TAS. Frequency: Very frequent (HP:0040281). (ORPHA:85174)
- Scoliosis (HP:0002650): The presence of an abnormal lateral curvature of the spine. Evidence: TAS. Frequency: Very frequent (HP:0040281). (ORPHA:85174)
- Elbow dislocation (HP:0003042): Dislocation of the distal humerus out of the elbow joint, where the radius, ulna, and humerus meet. Evidence: TAS. Frequency: Very frequent (HP:0040281). (ORPHA:85174)
- Phalangeal dislocation (HP:0006243). Evidence: TAS. Frequency: Very frequent (HP:0040281). (ORPHA:85174)
- Rhizomelia (HP:0008905): Disproportionate shortening of the proximal segment of limbs (i.e. the femur and humerus). Evidence: TAS. Frequency: Very frequent (HP:0040281). (ORPHA:85174)
- Omphalocele (HP:0001539): A midline anterior incomplete closure of the abdominal wall in which there is herniation of the abdominal viscera into the base of the abdominal cord. Evidence: TAS. Frequency: Occasional (HP:0040283). (ORPHA:85174)
- Abnormal cardiovascular system morphology (HP:0030680): Any structural anomaly of the heart and blood vessels. Evidence: TAS. Frequency: Occasional (HP:0040283). (ORPHA:85174)